Phenotypes associated with the disease Hailey-Hailey disease (ORPHA:2841):
- Hyperkeratosis (HP:0000962): Hyperkeratosis is a histopathological term defining a thickened stratum corneum and may be present in many different skin conditions, with many possible overlaps. Hyperkeratosis refers to the increased thickness of the stratum corneum, the outer layer of the skin. Hyperkeratosis is subclassified as orthokeratotic or parakeratotic. Orthokeratotic hyperkeratosis refers to the thickening of the keratin layer with preserved keratinocyte maturation, while parakeratotic hyperkeratosis shows retained nuclei as a sign of delayed maturation of keratinocytes. Evidence: TAS. Frequency: Very frequent (HP:0040281). (ORPHA:2841)
- Erythema (HP:0010783): Redness of the skin, caused by hyperemia of the capillaries in the lower layers of the skin. Evidence: TAS. Frequency: Very frequent (HP:0040281). (ORPHA:2841)
- Acantholysis (HP:0100792): The loss of intercellular connections, such as desmosomes, resulting in loss of cohesion between keratinocytes. Evidence: TAS. Frequency: Very frequent (HP:0040281). (ORPHA:2841)
- Skin erosion (HP:0200041): A discontinuity of the skin exhibiting incomplete loss of the epidermis, a lesion that is moist, circumscribed, and usually depressed. Evidence: TAS. Frequency: Very frequent (HP:0040281). (ORPHA:2841)
- Skin vesicle (HP:0200037): A circumscribed, fluid-containing, epidermal elevation less than 10mm in diameter at the widest point that (i) Contain serous exudates or serum mixed with blood or pus; (ii) Are discrete, grouped, irregularly distributed, or linear as in Rhus dermatitis; (iii) Are short-lived. Vesicles may break spontaneously or evolve into bullae by enlarging or coalescing with other vesicles. Evidence: TAS. Frequency: Very frequent (HP:0040281). (ORPHA:2841)